Phenotypes associated with the disease spermatogenic failure 33 (OMIM:618152):
- Irregularly shaped sperm tail (HP:0033393): Irregular or changing caliber (diameter) along the tail of the sperm. Evidence: PCS. Frequency: 6/6. (PMID:30122540)
- Coiled sperm flagella (HP:0032560): Sperm cells whose flagella are twisted (coiled). Evidence: PCS. Frequency: 6/6. (PMID:30122540)
- Male infertility (HP:0003251). Evidence: PCS. Frequency: 7/7. (PMID:30122540)
- Young adult onset (HP:0011462): Onset of disease at the age of between 16 and 40 years. Evidence: PCS. Frequency: 7/7. (PMID:30122540)
- Autosomal recessive inheritance (HP:0000007): A mode of inheritance that is observed for traits related to a gene encoded on one of the autosomes (i.e., the human chromosomes 1-22) in which a trait manifests in individuals with two pathogenic alleles, either homozygotes (two copies of the same mutant allele) or compound heterozygotes (whereby each copy of a gene has a distinct mutant allele). Evidence: PCS. (PMID:30122540)
- Reduced sperm motility (HP:0012207): An abnormal reduction in the mobility of ejaculated sperm. Evidence: PCS. Frequency: 7/7. (PMID:30122540)
- Absent sperm flagella (HP:0032558): Sperm cells lacking flagella. Evidence: PCS. Frequency: 6/6. (PMID:30122540)
- Short sperm flagella (HP:0032559): Sperm cells with abnormally short flagella. Evidence: PCS. Frequency: 6/6. (PMID:30122540)